- Protruding ear (HP:0000411): Angle formed by the plane of the ear and the mastoid bone greater than the 97th centile for age (objective); or, outer edge of the helix more than 2 cm from the mastoid at the point of maximum distance (objective). Evidence: TAS. Frequency: Very frequent (HP:0040281). (ORPHA:3304)
- Severe failure to thrive (HP:0001525). Evidence: TAS. Frequency: Very frequent (HP:0040281). (ORPHA:3304)
- Profound intellectual disability (HP:0002187): Profound intellectual disability (ID) is defined as a type of ID characterized by profoundly sub-average adaptive functioning and intellectual functioning, with an intelligence quotient (IQ) below 20. Evidence: TAS. Frequency: Very frequent (HP:0040281). (ORPHA:3304)
- Cryptorchidism (HP:0000028): Testis in inguinal canal. That is, absence of one or both testes from the scrotum owing to failure of the testis or testes to descend through the inguinal canal to the scrotum. Evidence: TAS. Frequency: Frequent (HP:0040282). (ORPHA:3304)
- High palate (HP:0000218): Height of the palate more than 2 SD above the mean (objective) or palatal height at the level of the first permanent molar more than twice the height of the teeth (subjective). Evidence: TAS. Frequency: Frequent (HP:0040282). (ORPHA:3304)
- Microcephaly (HP:0000252): Head circumference below 2 standard deviations below the mean for age and gender. Evidence: TAS. Frequency: Frequent (HP:0040282). (ORPHA:3304)
- Micrognathia (HP:0000347): Developmental hypoplasia of the mandible. Evidence: TAS. Frequency: Frequent (HP:0040282). (ORPHA:3304)
- Macrotia (HP:0000400): Median longitudinal ear length greater than two standard deviations above the mean and median ear width greater than two standard deviations above the mean (objective); or, apparent increase in length and width of the pinna (subjective). Evidence: TAS. Frequency: Frequent (HP:0040282). (ORPHA:3304)
- Downslanted palpebral fissures (HP:0000494): The palpebral fissure inclination is more than two standard deviations below the mean. Evidence: TAS. Frequency: Frequent (HP:0040282). (ORPHA:3304)
- Single transverse palmar crease (HP:0000954): The distal and proximal transverse palmar creases are merged into a single transverse palmar crease. Evidence: TAS. Frequency: Frequent (HP:0040282). (ORPHA:3304)
- Atrial septal defect (HP:0001631): Atrial septal defect (ASD) is a congenital abnormality of the interatrial septum that enables blood flow between the left and right atria via the interatrial septum. Evidence: TAS. Frequency: Frequent (HP:0040282). (ORPHA:3304)
- Tetralogy of Fallot (HP:0001636): A congenital cardiac malformation comprising pulmonary stenosis, overriding aorta, ventricular septum defect, and right ventricular hypertrophy. The diagnosis of TOF is made if at least three of the four above mentioned features are present. Evidence: TAS. Frequency: Frequent (HP:0040282). (ORPHA:3304)
- Pulmonic stenosis (HP:0001642): A narrowing of the right ventricular outflow tract that can occur at the pulmonary valve (valvular stenosis), below the pulmonary valve (infundibular stenosis), or above the pulmonary valve (supravalvar stenosis). Evidence: TAS. Frequency: Frequent (HP:0040282). (ORPHA:3304)
- Double outlet right ventricle (HP:0001719): Double outlet right ventricle (DORV) is a type of ventriculoarterial connection in which both great vessels arise entirely or predominantly from the right ventricle. Evidence: TAS. Frequency: Frequent (HP:0040282). (ORPHA:3304)
- 2-3 toe syndactyly (HP:0004691): Syndactyly with fusion of toes two and three. Evidence: TAS. Frequency: Frequent (HP:0040282). (ORPHA:3304)
- Frontal hirsutism (HP:0011335): Excessive amount of hair growth on forehead. Evidence: TAS. Frequency: Frequent (HP:0040282). (ORPHA:3304)
- Severe global developmental delay (HP:0011344): A severe delay in the achievement of motor or mental milestones in the domains of development of a child. Evidence: TAS. Frequency: Frequent (HP:0040282). (ORPHA:3304)
- Thin upper lip vermilion (HP:0000219): Height of the vermilion of the upper lip in the midline more than 2 SD below the mean. Alternatively, an apparently reduced height of the vermilion of the upper lip in the frontal view (subjective). Evidence: TAS. Frequency: Occasional (HP:0040283). (ORPHA:3304)
- Hypertelorism (HP:0000316): Interpupillary distance more than 2 SD above the mean (alternatively, the appearance of an increased interpupillary distance or widely spaced eyes). Evidence: TAS. Frequency: Occasional (HP:0040283). (ORPHA:3304)
- High forehead (HP:0000348): An abnormally increased height of the forehead. Evidence: TAS. Frequency: Occasional (HP:0040283). (ORPHA:3304)
- Recurrent otitis media (HP:0000403): Increased susceptibility to otitis media, as manifested by recurrent episodes of otitis media. Evidence: TAS. Frequency: Occasional (HP:0040283). (ORPHA:3304)
- Wide nasal bridge (HP:0000431): Increased breadth of the nasal bridge (and with it, the nasal root). Evidence: TAS. Frequency: Occasional (HP:0040283). (ORPHA:3304)
- Strabismus (HP:0000486): A misalignment of the eyes so that the visual axes deviate from bifoveal fixation. The classification of strabismus may be based on a number of features including the relative position of the eyes, whether the deviation is latent or manifest, intermittent or constant, concomitant or otherwise and according to the age of onset and the relevance of any associated refractive error. Evidence: TAS. Frequency: Occasional (HP:0040283). (ORPHA:3304)
- Cyanosis (HP:0000961): Bluish discoloration of the skin and mucosa due to poor circulation or inadequate oxygenation of arterial or capillary blood. Evidence: TAS. Frequency: Occasional (HP:0040283). (ORPHA:3304)
- Hypertonia (HP:0001276): A condition in which there is increased muscle tone so that arms or legs, for example, are stiff and difficult to move. Evidence: TAS. Frequency: Occasional (HP:0040283). (ORPHA:3304)
- Patent ductus arteriosus (HP:0001643): In utero, the ductus arteriosus (DA) serves to divert ventricular output away from the lungs and toward the placenta by connecting the main pulmonary artery to the descending aorta. A patent ductus arteriosus (PDA) in the first 3 days of life is a physiologic shunt in healthy term and preterm newborn infants, and normally is substantially closed within about 24 hours after bith and completely closed after about three weeks. Failure of physiologcal closure is referred to a persistent or patent ductus arteriosus (PDA). Depending on the degree of left-to-right shunting, PDA can have clinical consequences. Evidence: TAS. Frequency: Occasional (HP:0040283). (ORPHA:3304)
- Opisthotonus (HP:0002179): Opisthotonus is defined as a dramatic abnormal posture due to spastic contraction of the extensor muscles of the neck, trunk, and lower extremities that produces a severe backward arching from neck to heel. In most cases, the trunk is elevated off the ground by a few inches. It is usually sudden in onset and can be sustained or repetitive. It can be considered a variant of decerebrate posturing involving a hyperextension of the neck, back, and limbs. Evidence: TAS. Frequency: Occasional (HP:0040283). (ORPHA:3304)
- Overriding aorta (HP:0002623): An overriding aorta is a congenital heart defect where the aorta is positioned directly over a ventricular septal defect, instead of over the left ventricle. The result is that the aorta receives some blood from the right ventricle, which reduces the amount of oxygen in the blood. It is one of the four conditions of the Tetralogy of Fallot. The aortic root can be displaced toward the front (anteriorly) or directly above the septal defect, but it is always abnormally located to the right of the root of the pulmonary artery. The degree of override is quite variable, with 5-95% of the valve being connected to the right ventricle. Evidence: TAS. Frequency: Occasional (HP:0040283). (ORPHA:3304)
- Hypoplastic nasal tip (HP:0005278). Evidence: TAS. Frequency: Occasional (HP:0040283). (ORPHA:3304)
- Persistent left superior vena cava (HP:0005301): A rare congenital vascular anomaly that results when the left superior cardinal vein caudal to the innominate vein fails to regress. Evidence: TAS. Frequency: Occasional (HP:0040283). (ORPHA:3304)
- Unilateral ptosis (HP:0007687): A unilateral form of ptosis. Evidence: TAS. Frequency: Occasional (HP:0040283). (ORPHA:3304)
- Clubbing of fingers (HP:0100759): Terminal broadening of the fingers (distal phalanges of the fingers). Evidence: TAS. Frequency: Occasional (HP:0040283). (ORPHA:3304)
- Clubbing of toes (HP:0100760): Terminal broadening of the toes (distal phalanges of the toes). Evidence: TAS. Frequency: Occasional (HP:0040283). (ORPHA:3304)
These phenotypes are associated with the disease Fallot complex-intellectual disability-growth delay syndrome (ORPHA:3304).